Phenotypes associated with the disease autosomal dominant nonsyndromic hearing loss 31 (OMIM:608645):
- Old-aged sensorineural hearing impairment (HP:0040113). Evidence: TAS. (OMIM:608645)
- Autosomal dominant inheritance (HP:0000006): A mode of inheritance that is observed for traits related to a gene encoded on one of the autosomes (i.e., the human chromosomes 1-22) in which a trait manifests in heterozygotes. In the context of medical genetics, an autosomal dominant disorder is caused when a single copy of the mutant allele is present. Males and females are affected equally, and can both transmit the disorder with a risk of 50% for each child of inheriting the mutant allele. Evidence: TAS. (OMIM:608645)